- Microcephaly (HP:0000252): Head circumference below 2 standard deviations below the mean for age and gender. Evidence: TAS. (OMIM:241000)
- 2-4 toe syndactyly (HP:0010714): Syndactyly with fusion of toes two to four. Evidence: TAS. (OMIM:241000)
- Autosomal recessive inheritance (HP:0000007): A mode of inheritance that is observed for traits related to a gene encoded on one of the autosomes (i.e., the human chromosomes 1-22) in which a trait manifests in individuals with two pathogenic alleles, either homozygotes (two copies of the same mutant allele) or compound heterozygotes (whereby each copy of a gene has a distinct mutant allele). Evidence: TAS. (OMIM:241000)
- Male hypogonadism (HP:0000026): Decreased functionality of the male gonad, i.e., of the testis, with reduced spermatogenesis or testosterone synthesis. Evidence: TAS. (OMIM:241000)
- Syndactyly (HP:0001159): Webbing or fusion of the fingers or toes, involving soft parts only or including bone structure. Bony fusions are referred to as "bony" syndactyly if the fusion occurs in a radio-ulnar axis. Fusions of bones of the fingers or toes in a proximo-distal axis are referred to as "symphalangism". Evidence: TAS. (OMIM:241000)
- Intellectual disability (HP:0001249): The term intellectual disability or intellectual developmental disorder is used to describe significantly sub-average intellectual and adaptive functioning based on clinical assessment and as measured by individually administered, appropriately normed, standardized and validated tests of intellectual functioning and adaptive behavior, with onset during the developmental period from infancy through adolescence. Evidence: TAS. (OMIM:241000)
- Azoospermia (HP:0000027): Absence of any measurable level of sperm,whereby spermatozoa cannot be observed even after centrifugation of the semen pellet. Evidence: TAS. (OMIM:241000)
These phenotypes are associated with the disease hypogonadism with low-grade mental deficiency and microcephaly (OMIM:241000).